Phenotypes associated with the disease Ganglioneuroma (ORPHA:251992):
- Ganglioneuroma (HP:0003005): A benign neoplasm that usually arises from the sympathetic trunk in the mediastinum, representing a tumor of the sympathetic nerve fibers arising from neural crest cells. Evidence: TAS. Frequency: Obligate (HP:0040280). (ORPHA:251992)
- Abnormality of the adrenal glands (HP:0000834): Abnormality of the adrenal glands, i.e., of the endocrine glands located at the top of the kindneys. Evidence: TAS. Frequency: Frequent (HP:0040282). (ORPHA:251992)
- Multiple intestinal neurofibromatosis (HP:0005220). Evidence: TAS. Frequency: Frequent (HP:0040282). (ORPHA:251992)
- Abnormal mediastinum morphology (HP:0045026): Any structural anomaly of the central compartment of the thoracic cavity. Evidence: TAS. Frequency: Frequent (HP:0040282). (ORPHA:251992)
- Colorectal polyposis (HP:0200063): Multiple abnormal growths that arise from the lining of the large intestine (colon or rectum) and protrude into the intestinal lumen. Evidence: TAS. Frequency: Frequent (HP:0040282). (ORPHA:251992)
- Hypertension (HP:0000822): The presence of chronic increased pressure in the systemic arterial system. Evidence: TAS. Frequency: Occasional (HP:0040283). (ORPHA:251992)
- Episodic abdominal pain (HP:0002574): An intermittent form of abdominal pain. Evidence: TAS. Frequency: Occasional (HP:0040283). (ORPHA:251992)
- Hamartomatous polyposis (HP:0004390): Polyp-like protrusions which are histologically hamartomas. These can occur throughout the gastrointestinal tract. Hamartomatous polyps are composed of the normal cellular elements of the gastrointestinal tract, but have a markedly distorted architecture. Evidence: TAS. Frequency: Occasional (HP:0040283). (ORPHA:251992)
- Functional intestinal obstruction (HP:0005249). Evidence: TAS. Frequency: Occasional (HP:0040283). (ORPHA:251992)
- Neoplasm of the adrenal gland (HP:0100631): A tumor (abnormal growth of tissue) of the adrenal gland. Evidence: TAS. Frequency: Occasional (HP:0040283). (ORPHA:251992)
- Abnormality of the orbital region (HP:0000315). Evidence: TAS. Frequency: Very rare (HP:0040284). (ORPHA:251992)
- Abnormal rectum morphology (HP:0002034): An abnormaltiy of the rectum, the final segment of the large intestine that stores solid waste until it passes through the anus. Evidence: TAS. Frequency: Very rare (HP:0040284). (ORPHA:251992)
- Gastrointestinal hemorrhage (HP:0002239): Hemorrhage affecting the gastrointestinal tract. Evidence: TAS. Frequency: Very rare (HP:0040284). (ORPHA:251992)
- Abnormal bone structure (HP:0003330): Any anomaly in the composite material or the layered arrangement of the bony skeleton. Evidence: TAS. Frequency: Very rare (HP:0040284). (ORPHA:251992)
- Central hypoventilation (HP:0007110). Evidence: TAS. Frequency: Very rare (HP:0040284). (ORPHA:251992)
- Abnormal prostate morphology (HP:0008775): An abnormality of the prostate. Evidence: TAS. Frequency: Very rare (HP:0040284). (ORPHA:251992)